- Obstructive sleep apnea (HP:0002870): Obstructive Sleep Apnea is a condition characterized by the obstruction of the airway and pauses in breathing during sleep, which occur multiple times throughout the night. It is related to the relaxation of muscle tone that typically happens during sleep, leading to a partial collapse of the soft tissues in the airway and causing airflow obstruction. Evidence: PCS. Frequency: 3/6. (PMID:21907016)
- Hypnagogic hallucination (HP:0002519): Hypnagogic hallucinations are brief hallucinations that occur when falling asleep. Evidence: PCS. Frequency: 3/6. (PMID:21907016)
- Young adult onset (HP:0011462): Onset of disease at the age of between 16 and 40 years. Evidence: PCS. Frequency: 6/6. (PMID:21907016)
- Excessive daytime somnolence (HP:0001262): A state of abnormally strong desire for sleep during the daytime. Evidence: PCS. Frequency: 6/6. Onset: Young adult onset (HP:0011462). (PMID:21907016)
- Sleep paralysis (HP:0025233): Inability to move trunk and limbs and inability to speak during transition into or out of sleep; awareness is preserved and recall is present. Evidence: PCS. Frequency: 3/6. (PMID:21907016)
- Cataplexy (HP:0002524): A sudden and transient episode of bilateral loss of muscle tone, often triggered by emotions. Evidence: PCS. Frequency: 6/6. Onset: Young adult onset (HP:0011462). (PMID:21907016)
- Type II diabetes mellitus (HP:0005978): A type of diabetes mellitus initially characterized by insulin resistance and hyperinsulinemia and subsequently by glucose interolerance and hyperglycemia. Evidence: PCS. Frequency: 2/6. (PMID:21907016)
- Obesity (HP:0001513): Accumulation of substantial excess body fat. Evidence: PCS. Frequency: 5/6. (PMID:21907016)
- Autosomal dominant inheritance (HP:0000006): A mode of inheritance that is observed for traits related to a gene encoded on one of the autosomes (i.e., the human chromosomes 1-22) in which a trait manifests in heterozygotes. In the context of medical genetics, an autosomal dominant disorder is caused when a single copy of the mutant allele is present. Males and females are affected equally, and can both transmit the disorder with a risk of 50% for each child of inheriting the mutant allele. Evidence: PCS. (PMID:21907016)
These phenotypes are associated with the disease narcolepsy 7 (OMIM:614250).